Phenotypes associated with the disease diffuse cerebral and cerebellar atrophy - intractable seizures - progressive microcephaly syndrome (OMIM:615760):
- Epicanthus (HP:0000286): A fold of skin starting above the medial aspect of the upper eyelid and arching downward to cover, pass in front of and lateral to the medial canthus. Evidence: PCS. Frequency: 2/3. (PMID:24656866)
- Narrow forehead (HP:0000341): Width of the forehead or distance between the frontotemporales is more than two standard deviations below the mean (objective); or apparently narrow intertemporal region (subjective). Evidence: PCS. (PMID:24656866)
- Progressive (HP:0003676): Applies to a disease manifestation that increases in scope or severity over the course of time, i.e., that worsens with age. Evidence: PCS. (PMID:24656866)
- Sloping forehead (HP:0000340): Inclination of the anterior surface of the forehead from the vertical more than two standard deviations above the mean (objective); or apparently excessive posterior sloping of the forehead in a lateral view. Evidence: PCS. Frequency: 2/3. (PMID:24656866)
- Hypotonia (HP:0001252): Hypotonia is an abnormally low muscle tone (the amount of tension or resistance to movement in a muscle). Even when relaxed, muscles have a continuous and passive partial contraction which provides some resistance to passive stretching. Hypotonia thus manifests as diminished resistance to passive stretching. Hypotonia is not the same as muscle weakness, although the two conditions can co-exist. Evidence: PCS. Frequency: 3/4. (PMID:24656866)
- Infantile onset (HP:0003593): Onset of signs or symptoms of disease between 28 days to one year of life. Evidence: PCS. Frequency: 1/4. (PMID:24656866)
- Ventriculomegaly (HP:0002119): An increase in size of the ventricular system of the brain. Evidence: PCS. (PMID:24656866)
- CNS hypomyelination (HP:0003429): Reduced amount of myelin in the central nervous system resulting from defective myelinogenesis. Evidence: PCS. (PMID:24656866)
- High palate (HP:0000218): Height of the palate more than 2 SD above the mean (objective) or palatal height at the level of the first permanent molar more than twice the height of the teeth (subjective). Evidence: PCS. Frequency: 2/3. (PMID:24656866)
- Posteriorly rotated ears (HP:0000358): A type of abnormal location of the ears in which the position of the ears is characterized by posterior rotation (the superior part of the ears is rotated towards the back of the head, and the inferior part of the ears towards the front). Evidence: PCS. Frequency: 1/3. (PMID:24656866)
- Cerebellar vermis atrophy (HP:0006855): Wasting (atrophy) of the vermis of cerebellum. Evidence: PCS. (PMID:24656866)
- Hyperreflexia (HP:0001347): Hyperreflexia is the presence of hyperactive stretch reflexes of the muscles. Evidence: TAS. Frequency: Occasional (HP:0040283). (OMIM:615760)
- Neonatal onset (HP:0003623): Onset of signs or symptoms of disease within the first 28 days of life. Evidence: PCS. Frequency: 3/4. (PMID:24656866)
- Progressive microcephaly (HP:0000253): Progressive microcephaly is diagnosed when the head circumference falls progressively behind age- and gender-dependent norms. Evidence: PCS. Frequency: 4/4. (PMID:24656866)
- Cerebral atrophy (HP:0002059): Atrophy (wasting, decrease in size of cells or tissue) affecting the cerebrum. Evidence: PCS. (PMID:24656866)
- Microcephaly (HP:0000252): Head circumference below 2 standard deviations below the mean for age and gender. Evidence: PCS. Frequency: 4/4. (PMID:24656866)
- Status epilepticus (HP:0002133): Status epilepticus is a type of prolonged seizure resulting either from the failure of the mechanisms responsible for seizure termination or from the initiation of mechanisms which lead to abnormally prolonged seizures (after time point t1). It is a condition that can have long-term consequences (after time point t2), including neuronal death, neuronal injury, and alteration of neuronal networks, depending on the type and duration of seizures. Evidence: PCS. Frequency: 1/4. (PMID:24656866)
- Wide nasal bridge (HP:0000431): Increased breadth of the nasal bridge (and with it, the nasal root). Evidence: PCS. Frequency: 2/3. (PMID:24656866)
- Hypoplasia of the corpus callosum (HP:0002079): Underdevelopment of the corpus callosum. Evidence: PCS. (PMID:24656866)
- Profound global developmental delay (HP:0012736): A profound delay in the achievement of motor or mental milestones in the domains of development of a child. Evidence: PCS. Frequency: 4/4. (PMID:24656866)
- Depressed nasal bridge (HP:0005280): Posterior positioning of the nasal root in relation to the overall facial profile for age. Evidence: PCS. Frequency: 1/3. (PMID:24656866)
- Autosomal recessive inheritance (HP:0000007): A mode of inheritance that is observed for traits related to a gene encoded on one of the autosomes (i.e., the human chromosomes 1-22) in which a trait manifests in individuals with two pathogenic alleles, either homozygotes (two copies of the same mutant allele) or compound heterozygotes (whereby each copy of a gene has a distinct mutant allele). Evidence: PCS. (PMID:24656866)
- Hypotelorism (HP:0000601): Interpupillary distance less than 2 SD below the mean (alternatively, the appearance of an decreased interpupillary distance or closely spaced eyes). Evidence: PCS. Frequency: 2/3. (PMID:24656866)
- Low-set ears (HP:0000369): Upper insertion of the ear to the scalp below an imaginary horizontal line drawn between the inner canthi of the eye and extending posteriorly to the ear. Evidence: PCS. Frequency: 1/3. (PMID:24656866)
- Simplified gyral pattern (HP:0009879): An abnormality of the cerebral cortex with fewer gyri but with normal cortical thickness. This pattern is usually often associated with congenital microcephaly. Evidence: PCS. (PMID:24656866)